- Amelogenesis imperfecta (HP:0000705): A developmental dysplasia of the dental enamel. Evidence: PCS. Frequency: 2/2. (PMID:15744043)
- Anterior open-bite malocclusion (HP:0009102): Anterior open bite is a malocclusion characterized by a gap between the anterior teeth (incisors), that is, by a deficiency in the normal vertical overlap between antagonist incisal edges when the posterior teeth are in occlusion. Evidence: PCS. Frequency: 1/2. (PMID:15744043)
- Yellow-brown discoloration of the teeth (HP:0006286). Evidence: PCS. Frequency: 2/2. (PMID:15744043)
- Autosomal recessive inheritance (HP:0000007): A mode of inheritance that is observed for traits related to a gene encoded on one of the autosomes (i.e., the human chromosomes 1-22) in which a trait manifests in individuals with two pathogenic alleles, either homozygotes (two copies of the same mutant allele) or compound heterozygotes (whereby each copy of a gene has a distinct mutant allele). Evidence: PCS. (PMID:15744043)
- Hypomature enamel (HP:0033786): Enamel with a white or brown discoloration without hypoplasia. Evidence: PCS. Frequency: 2/2. (PMID:15744043)
These phenotypes are associated with the disease amelogenesis imperfecta hypomaturation type 2A2 (OMIM:612529).